Phenotypes associated with the disease Congenital labioscrotal agenesis-cerebellar malformation-corneal dystrophy-facial dysmorphism syndrome (ORPHA:495875):
- Cryptorchidism (HP:0000028): Testis in inguinal canal. That is, absence of one or both testes from the scrotum owing to failure of the testis or testes to descend through the inguinal canal to the scrotum. Evidence: TAS. Frequency: Very frequent (HP:0040281). (ORPHA:495875)
- Coarse facial features (HP:0000280): Absence of fine and sharp appearance of brows, nose, lips, mouth, and chin, usually because of rounded and heavy features or thickened skin with or without thickening of subcutaneous and bony tissues. Evidence: TAS. Frequency: Very frequent (HP:0040281). (ORPHA:495875)
- Low anterior hairline (HP:0000294): Distance between the hairline (trichion) and the glabella (the most prominent point on the frontal bone above the root of the nose), in the midline, more than two SD below the mean. Alternatively, an apparently decreased distance between the hairline and the glabella. Evidence: TAS. Frequency: Very frequent (HP:0040281). (ORPHA:495875)
- Small forehead (HP:0000350): The presence of a forehead that is abnormally small. Evidence: TAS. Frequency: Very frequent (HP:0040281). (ORPHA:495875)
- Horizontal nystagmus (HP:0000666): Nystagmus consisting of horizontal to-and-fro eye movements. Evidence: TAS. Frequency: Very frequent (HP:0040281). (ORPHA:495875)
- Corneal dystrophy (HP:0001131): The term corneal dystrophy embraces a heterogenous group of bilateral genetically determined non-inflammatory corneal diseases that are restricted to the cornea. Evidence: TAS. Frequency: Very frequent (HP:0040281). (ORPHA:495875)
- Corneal opacity (HP:0007957): A reduction of corneal clarity. Evidence: TAS. Frequency: Very frequent (HP:0040281). (ORPHA:495875)
- Absent scrotum (HP:0008707): Congenital absence of the scrotum. Evidence: TAS. Frequency: Very frequent (HP:0040281). (ORPHA:495875)
- Absence of labia majora (HP:0008729). Evidence: TAS. Frequency: Very frequent (HP:0040281). (ORPHA:495875)
- Broad eyebrow (HP:0011229): Regional increase in the width (height) of the eyebrow. Evidence: TAS. Frequency: Very frequent (HP:0040281). (ORPHA:495875)
- Sparse eyebrow (HP:0045075): Decreased density/number of eyebrow hairs. Evidence: TAS. Frequency: Very frequent (HP:0040281). (ORPHA:495875)
- Hypospadias (HP:0000047): Abnormal position of urethral meatus on the ventral penile shaft (underside) characterized by displacement of the urethral meatus from the tip of the glans penis to the ventral surface of the penis, scrotum, or perineum. Evidence: TAS. Frequency: Frequent (HP:0040282). (ORPHA:495875)
- Long philtrum (HP:0000343): Distance between nasal base and midline upper lip vermilion border more than 2 SD above the mean. Alternatively, an apparently increased distance between nasal base and midline upper lip vermilion border. Evidence: TAS. Frequency: Frequent (HP:0040282). (ORPHA:495875)
- Low-set ears (HP:0000369): Upper insertion of the ear to the scalp below an imaginary horizontal line drawn between the inner canthi of the eye and extending posteriorly to the ear. Evidence: TAS. Frequency: Frequent (HP:0040282). (ORPHA:495875)
- Anteverted nares (HP:0000463): Anteriorly-facing nostrils viewed with the head in the Frankfurt horizontal and the eyes of the observer level with the eyes of the subject. This gives the appearance of an upturned nose (upturned nasal tip). Evidence: TAS. Frequency: Frequent (HP:0040282). (ORPHA:495875)
- Abnormality of the eye (HP:0000478): Any abnormality of the eye, including location, spacing, and intraocular abnormalities. Evidence: TAS. Frequency: Frequent (HP:0040282). (ORPHA:495875)
- Strabismus (HP:0000486): A misalignment of the eyes so that the visual axes deviate from bifoveal fixation. The classification of strabismus may be based on a number of features including the relative position of the eyes, whether the deviation is latent or manifest, intermittent or constant, concomitant or otherwise and according to the age of onset and the relevance of any associated refractive error. Evidence: TAS. Frequency: Frequent (HP:0040282). (ORPHA:495875)
- Visual impairment (HP:0000505): Visual impairment (or vision impairment) is vision loss (of a person) to such a degree as to qualify as an additional support need through a significant limitation of visual capability resulting from either disease, trauma, or congenital or degenerative conditions that cannot be corrected by conventional means, such as refractive correction, medication, or surgery. Evidence: TAS. Frequency: Frequent (HP:0040282). (ORPHA:495875)
- Buphthalmos (HP:0000557): Diffusely large eye (with megalocornea) associated with glaucoma. Evidence: TAS. Frequency: Frequent (HP:0040282). (ORPHA:495875)
- Synophrys (HP:0000664): Meeting of the medial eyebrows in the midline. Evidence: TAS. Frequency: Frequent (HP:0040282). (ORPHA:495875)
- Hirsutism (HP:0001007): Abnormally increased hair growth referring to a male pattern of body hair (androgenic hair). Evidence: TAS. Frequency: Frequent (HP:0040282). (ORPHA:495875)
- Keratoconjunctivitis sicca (HP:0001097): Dryness of the eye related to deficiency of the tear film components (aqueous, mucin, or lipid), lid surface abnormalities, or epithelial abnormalities. Keratoconjunctivitis sicca often results in a scratchy or sandy sensation (foreign body sensation) in the eyes, and may also be associated with itching, inability to produce tears, photosensitivity, redness, pain, and difficulty in moving the eyelids. Evidence: TAS. Frequency: Frequent (HP:0040282). (ORPHA:495875)
- Dandy-Walker malformation (HP:0001305): A congenital brain malformation typically characterized by incomplete formation of the cerebellar vermis, dilation of the fourth ventricle, and enlargement of the posterior fossa. In layman's terms, Dandy Walker malformation is a cyst in the cerebellum (typically symmetrical) that is involved with the fourth ventricle. This may interfere with the ability to drain cerebrospinal fluid from the brain, resulting in hydrocephalus. Dandy Walker cysts are formed during early embryonic development, while the brain forms. The cyst in the cerebellum typically has several blood vessels running through it connecting to the brain, thereby prohibiting surgical removal. Evidence: TAS. Frequency: Frequent (HP:0040282). (ORPHA:495875)
- Cerebellar vermis hypoplasia (HP:0001320): Underdevelopment of the vermis of cerebellum. Evidence: TAS. Frequency: Frequent (HP:0040282). (ORPHA:495875)
- Broad-based gait (HP:0002136): An abnormal gait pattern in which persons stand and walk with their feet spaced widely apart. This is often a component of cerebellar ataxia. Evidence: TAS. Frequency: Frequent (HP:0040282). (ORPHA:495875)
- Postural instability (HP:0002172): A tendency to fall or the inability to keep oneself from falling; imbalance. The retropulsion test is widely regarded as the gold standard to evaluate postural instability, Use of the retropulsion test includes a rapid balance perturbation in the backward direction, and the number of balance correcting steps (or total absence thereof) is used to rate the degree of postural instability. Healthy subjects correct such perturbations with either one or two large steps, or without taking any steps, hinging rapidly at the hips while swinging the arms forward as a counterweight. In patients with balance impairment, balance correcting steps are often too small, forcing patients to take more than two steps. Taking three or more steps is generally considered to be abnormal, and taking more than five steps is regarded as being clearly abnormal. Markedly affected patients continue to step backward without ever regaining their balance and must be caught by the examiner (this would be called true retropulsion). Even more severely affected patients fail to correct entirely, and fall backward like a pushed toy soldier, without taking any corrective steps. Evidence: TAS. Frequency: Frequent (HP:0040282). (ORPHA:495875)
- Moderate intellectual disability (HP:0002342): Moderate intellectual disability (ID) is defined as a type of ID characterized by moderately sub-average adaptive functioning and intellectual functioning, with an intelligence quotient (IQ) the range of 35-49. Evidence: TAS. Frequency: Frequent (HP:0040282). (ORPHA:495875)
- Poor speech (HP:0002465). Evidence: TAS. Frequency: Frequent (HP:0040282). (ORPHA:495875)
- Depressed nasal bridge (HP:0005280): Posterior positioning of the nasal root in relation to the overall facial profile for age. Evidence: TAS. Frequency: Frequent (HP:0040282). (ORPHA:495875)
- Severe intellectual disability (HP:0010864): Severe intellectual disability (ID) is defined as a type of ID characterized by severely sub-average adaptive functioning and intellectual functioning, with an intelligence quotient (IQ) the range of 20-34. Evidence: TAS. Frequency: Frequent (HP:0040282). (ORPHA:495875)
- Moderate global developmental delay (HP:0011343): A moderate delay in the achievement of motor or mental milestones in the domains of development of a child. Evidence: TAS. Frequency: Frequent (HP:0040282). (ORPHA:495875)
- Severe global developmental delay (HP:0011344): A severe delay in the achievement of motor or mental milestones in the domains of development of a child. Evidence: TAS. Frequency: Frequent (HP:0040282). (ORPHA:495875)
- Tented philtrum (HP:0011825): Prominence of a triangular soft tissue area of the philtrum with the apex to the columella. Evidence: TAS. Frequency: Frequent (HP:0040282). (ORPHA:495875)
- Hypoplasia of the pons (HP:0012110): Underdevelopment of the pons. Evidence: TAS. Frequency: Frequent (HP:0040282). (ORPHA:495875)
- Hypoplastic labia minora (HP:0000064). Evidence: TAS. Frequency: Occasional (HP:0040283). (ORPHA:495875)
- Renal cyst (HP:0000107): A fluid filled sac in the kidney. Evidence: TAS. Frequency: Occasional (HP:0040283). (ORPHA:495875)
- Microcephaly (HP:0000252): Head circumference below 2 standard deviations below the mean for age and gender. Evidence: TAS. Frequency: Occasional (HP:0040283). (ORPHA:495875)
- Micrognathia (HP:0000347): Developmental hypoplasia of the mandible. Evidence: TAS. Frequency: Occasional (HP:0040283). (ORPHA:495875)
- Broad nasal tip (HP:0000455): Increase in width of the nasal tip. Evidence: TAS. Frequency: Occasional (HP:0040283). (ORPHA:495875)
- Short neck (HP:0000470): Diminished length of the neck. Evidence: TAS. Frequency: Occasional (HP:0040283). (ORPHA:495875)
- Long eyelashes (HP:0000527): Mid upper eyelash length >10 mm or increased length of the eyelashes (subjective). Evidence: TAS. Frequency: Occasional (HP:0040283). (ORPHA:495875)
- Optic nerve hypoplasia (HP:0000609): Underdevelopment of the optic nerve. Evidence: TAS. Frequency: Occasional (HP:0040283). (ORPHA:495875)
- Aggressive behavior (HP:0000718): Behavior or an act aimed at harming a person, animal, or physical property (e.g., acts of physical violence; shouting, swearing, and using harsh language; slashing someone's tires). Evidence: TAS. Frequency: Occasional (HP:0040283). (ORPHA:495875)
- Cerebellar hypoplasia (HP:0001321): Cerebellar hypoplasia is a descriptive term implying a cerebellum with a reduced volume, but a normal shape and is stable over time. Evidence: TAS. Frequency: Occasional (HP:0040283). (ORPHA:495875)
- Slurred speech (HP:0001350): Abnormal coordination of muscles involved in speech. Evidence: TAS. Frequency: Occasional (HP:0040283). (ORPHA:495875)
- Anteriorly placed anus (HP:0001545): Anterior malposition of the anus. Evidence: TAS. Frequency: Occasional (HP:0040283). (ORPHA:495875)
- Short columella (HP:0002000): Reduced distance from the anterior border of the naris to the subnasale. Evidence: TAS. Frequency: Occasional (HP:0040283). (ORPHA:495875)
- Gastroesophageal reflux (HP:0002020): A condition in which the stomach contents leak backwards from the stomach into the esophagus through the lower esophageal sphincter. Evidence: TAS. Frequency: Occasional (HP:0040283). (ORPHA:495875)
- Wide intermamillary distance (HP:0006610): A larger than usual distance between the left and right nipple. Evidence: TAS. Frequency: Occasional (HP:0040283). (ORPHA:495875)
- Attention deficit hyperactivity disorder (HP:0007018): Attention deficit hyperactivity disorder (ADHD) manifests at age 2-3 years or by first grade at the latest. The main symptoms are distractibility, impulsivity, hyperactivity, and often trouble organizing tasks and projects, difficulty going to sleep, and social problems from being aggressive, loud, or impatient. Evidence: TAS. Frequency: Occasional (HP:0040283). (ORPHA:495875)
- Visual fixation instability (HP:0025405): A deficit in the ability to fixate eye movements in order to stabilize images on the retina. Evidence: TAS. Frequency: Occasional (HP:0040283). (ORPHA:495875)
- Decreased serum testosterone concentration (HP:0040171). Evidence: TAS. Frequency: Occasional (HP:0040283). (ORPHA:495875)